- Microcephaly (HP:0000252): Head circumference below 2 standard deviations below the mean for age and gender. Evidence: IEA. (DECIPHER:4)
- EEG abnormality (HP:0002353): Abnormality observed by electroencephalogram (EEG), which is used to record of the brain's spontaneous electrical activity from multiple electrodes placed on the scalp. Evidence: IEA. (DECIPHER:4)
- Truncal ataxia (HP:0002078): Truncal ataxia is a sign of ataxia characterized by instability of the trunk. It usually occurs during sitting. Evidence: IEA. (DECIPHER:4)
- Seizure (HP:0001250): A seizure is an intermittent abnormality of nervous system physiology characterized by a transient occurrence of signs and/or symptoms due to abnormal excessive or synchronous neuronal activity in the brain. Evidence: IEA. (DECIPHER:4)
- Intellectual disability (HP:0001249): The term intellectual disability or intellectual developmental disorder is used to describe significantly sub-average intellectual and adaptive functioning based on clinical assessment and as measured by individually administered, appropriately normed, standardized and validated tests of intellectual functioning and adaptive behavior, with onset during the developmental period from infancy through adolescence. Evidence: IEA. (DECIPHER:4)
These phenotypes are associated with the disease Angelman syndrome (DECIPHER:4).